Phenotypes associated with the disease Cold-induced sweating syndrome 1 (OMIM:272430):
- Facial palsy (HP:0010628): Facial nerve palsy is a dysfunction of cranial nerve VII (the facial nerve) that results in inability to control facial muscles on the affected side with weakness of the muscles of facial expression and eye closure. This can either be present in unilateral or bilateral form. Evidence: TAS. (OMIM:272430)
- Limited elbow extension (HP:0001377): Limited ability to straighten the arm at the elbow joint. Evidence: IEA. (OMIM:272430)
- Long philtrum (HP:0000343): Distance between nasal base and midline upper lip vermilion border more than 2 SD above the mean. Alternatively, an apparently increased distance between nasal base and midline upper lip vermilion border. Evidence: TAS. (OMIM:272430)
- Anteverted nares (HP:0000463): Anteriorly-facing nostrils viewed with the head in the Frankfurt horizontal and the eyes of the observer level with the eyes of the subject. This gives the appearance of an upturned nose (upturned nasal tip). Evidence: TAS. (OMIM:272430)
- Seizure (HP:0001250): A seizure is an intermittent abnormality of nervous system physiology characterized by a transient occurrence of signs and/or symptoms due to abnormal excessive or synchronous neuronal activity in the brain. Evidence: TAS. Frequency: Occasional (HP:0040283). (OMIM:272430)
- Narrow mouth (HP:0000160): Distance between the commissures of the mouth more than 2 SD below the mean. Alternatively, an apparently decreased width of the oral aperture (subjective). Evidence: TAS. (OMIM:272430)
- Large face (HP:0100729). Evidence: TAS. (OMIM:272430)
- Feeding difficulties in infancy (HP:0008872): Impaired feeding performance of an infant as manifested by difficulties such as weak and ineffective sucking, brief bursts of sucking, and falling asleep during sucking. There may be difficulties with chewing or maintaining attention. Evidence: IEA. (OMIM:272430)
- Hyperhidrosis (HP:0000975): Abnormal excessive perspiration (sweating) despite the lack of appropriate stimuli like hot and humid weather. Evidence: PCS. (PMID:12509788)
- Radial deviation of finger (HP:0009466): Bending or curvature of a finger toward the radial side (i.e., towards the thumb). The deviation is at the metacarpal-phalangeal joint, and this finding is distinct from clinodactyly. Evidence: IEA. (OMIM:272430)
- High palate (HP:0000218): Height of the palate more than 2 SD above the mean (objective) or palatal height at the level of the first permanent molar more than twice the height of the teeth (subjective). Evidence: IEA. (OMIM:272430)
- Pes planus (HP:0001763): A foot where the longitudinal arch of the foot is in contact with the ground or floor when the individual is standing; or, in a patient lying supine, a foot where the arch is in contact with the surface of a flat board pressed against the sole of the foot by the examiner with a pressure similar to that expected from weight bearing; or, the height of the arch is reduced. Evidence: IEA. (OMIM:272430)
- Retrognathia (HP:0000278): An abnormality in which the mandible is mislocalised posteriorly. Evidence: TAS. (OMIM:272430)
- Intellectual disability (HP:0001249): The term intellectual disability or intellectual developmental disorder is used to describe significantly sub-average intellectual and adaptive functioning based on clinical assessment and as measured by individually administered, appropriately normed, standardized and validated tests of intellectual functioning and adaptive behavior, with onset during the developmental period from infancy through adolescence. Evidence: TAS. Frequency: Occasional (HP:0040283). (OMIM:272430)
- Kyphoscoliosis (HP:0002751): An abnormal curvature of the spine in both a coronal (lateral) and sagittal (back-to-front) plane. Evidence: IEA. (OMIM:272430)
- Opisthotonus (HP:0002179): Opisthotonus is defined as a dramatic abnormal posture due to spastic contraction of the extensor muscles of the neck, trunk, and lower extremities that produces a severe backward arching from neck to heel. In most cases, the trunk is elevated off the ground by a few inches. It is usually sudden in onset and can be sustained or repetitive. It can be considered a variant of decerebrate posturing involving a hyperextension of the neck, back, and limbs. Evidence: TAS. (OMIM:272430)
- Carious teeth (HP:0000670): Caries is a multifactorial bacterial infection affecting the structure of the tooth. This term has been used to describe the presence of more than expected dental caries. Evidence: TAS. (OMIM:272430)
- Short palm (HP:0004279): Short palm. Evidence: IEA. (OMIM:272430)
- Talipes equinovarus (HP:0001762): Talipes equinovarus (also called clubfoot) typically has four main components: inversion and adduction of the forefoot; inversion of the heel and hindfoot; equinus (limitation of extension) of the ankle and subtalar joint; and internal rotation of the leg. Evidence: TAS. (OMIM:272430)
- Trismus (HP:0000211): Limitation in the ability to open the mouth. Evidence: IEA. (OMIM:272430)
- Full cheeks (HP:0000293): Increased prominence or roundness of soft tissues between zygomata and mandible. Evidence: TAS. (OMIM:272430)
- Keratitis (HP:0000491): Inflammation of the cornea. Evidence: IEA. (OMIM:272430)
- Short neck (HP:0000470): Diminished length of the neck. Evidence: TAS. (OMIM:272430)
- Dyspnea (HP:0002094): Difficult or labored breathing. Dyspnea is a subjective feeling only the patient can rate, e.g., on a Borg scale. Evidence: TAS. (OMIM:272430)
- Tapered finger (HP:0001182): The gradual reduction in girth of the finger from proximal to distal. Evidence: IEA. (OMIM:272430)
- Adducted thumb (HP:0001181): In the resting position, the tip of the thumb is on, or near, the palm, close to the base of the fourth or fifth finger. Evidence: TAS. (OMIM:272430)
- Depressed nasal bridge (HP:0005280): Posterior positioning of the nasal root in relation to the overall facial profile for age. Evidence: IEA. (OMIM:272430)
- Camptodactyly (HP:0012385): The distal interphalangeal joint and/or the proximal interphalangeal joint of the fingers or toes cannot be extended to 180 degrees by either active or passive extension. Evidence: TAS. (OMIM:272430)
- Autosomal recessive inheritance (HP:0000007): A mode of inheritance that is observed for traits related to a gene encoded on one of the autosomes (i.e., the human chromosomes 1-22) in which a trait manifests in individuals with two pathogenic alleles, either homozygotes (two copies of the same mutant allele) or compound heterozygotes (whereby each copy of a gene has a distinct mutant allele). Evidence: IEA. (OMIM:272430)
- Recurrent fever (HP:0001954): Periodic (episodic or recurrent) bouts of fever. Evidence: TAS. (OMIM:272430)
- Elbow flexion contracture (HP:0002987): An elbow contracture that limits the ability of the elbow joint to be extended (straightened), meaning that the elbow is fixed in an flexed (bent) position. Evidence: TAS. (OMIM:272430)
- Low-set ears (HP:0000369): Upper insertion of the ear to the scalp below an imaginary horizontal line drawn between the inner canthi of the eye and extending posteriorly to the ear. Evidence: TAS. (OMIM:272430)
- Micrognathia (HP:0000347): Developmental hypoplasia of the mandible. Evidence: TAS. (OMIM:272430)
- Hypernasal speech (HP:0001611): A type of speech characterized by the presence of an abnormally increased nasal airflow during speech associated with structural abnormality of the nasal passages. Evidence: IEA. (OMIM:272430)
- Wide nose (HP:0000445): Interalar distance more than two standard deviations above the mean for age, i.e., an apparently increased width of the nasal base and alae. Evidence: TAS. (OMIM:272430)